Phenotypes associated with the disease alveolar soft part sarcoma (OMIM:606243):
- Typified by somatic mosaicism (HP:0001442): Description of conditions in which affected individuals typically display somatic mosaicism, i.e., genetically distinct populations of somatic cells in a given organism caused by DNA mutations, epigenetic alterations of DNA, chromosomal abnormalities or the spontaneous reversion of inherited mutations. In many conditions typified by somatic mosaicism, constitutive mutation is lethal and cases are exclusively or predominantly mosaic. Evidence: TAS. (OMIM:606243)
- Alveolar soft part sarcoma (HP:0012218): A type of soft tissue sarcoma with a histological appearance reminiscent of alveoli because of its reticulated fibrous stroma enclosing groups of sarcoma cells, which resemble epithelial cells and are enclosed in alveoli walled with connective tissue. Evidence: TAS. (OMIM:606243)